- Chorea (HP:0002072): Chorea (Greek for 'dance') refers to widespread arrhythmic involuntary movements of a forcible, jerky and restless fashion. It is a random-appearing sequence of one or more discrete involuntary movements or movement fragments. Movements appear random because of variability in timing, duration or location. Each movement may have a distinct start and end. However, movements may be strung together and thus may appear to flow randomly from one muscle group to another. Chorea can involve the trunk, neck, face, tongue, and extremities. Evidence: IEA. (OMIM:215450)
- Autosomal recessive inheritance (HP:0000007): A mode of inheritance that is observed for traits related to a gene encoded on one of the autosomes (i.e., the human chromosomes 1-22) in which a trait manifests in individuals with two pathogenic alleles, either homozygotes (two copies of the same mutant allele) or compound heterozygotes (whereby each copy of a gene has a distinct mutant allele). Evidence: IEA. (OMIM:215450)
These phenotypes are associated with the disease chorea, benign familial (OMIM:215450).